Phenotypes associated with the disease Bifid nose (ORPHA:2695):
- Hypertelorism (HP:0000316): Interpupillary distance more than 2 SD above the mean (alternatively, the appearance of an increased interpupillary distance or widely spaced eyes). Evidence: TAS. Frequency: Occasional (HP:0040283). (ORPHA:2695)
- Bifid nose (HP:0011803): Visually assessable vertical indentation, cleft, or depression of the nasal bridge, ridge and tip. Evidence: TAS. Frequency: Very frequent (HP:0040281). (ORPHA:2695)